- Hepatic failure (HP:0001399). Evidence: TAS. Frequency: Very frequent (HP:0040281). (ORPHA:2724)
- Dysphagia (HP:0002015): Difficulty in swallowing. Evidence: TAS. Frequency: Very frequent (HP:0040281). (ORPHA:2724)
- Atherosclerosis (HP:0002621): A condition characterized by patchy atheromas or atherosclerotic plaques which develop in the walls of medium-sized and large arteries and can lead to arterial stenosis with reduced or blocked blood flow. Evidence: TAS. Frequency: Very frequent (HP:0040281). (ORPHA:2724)
- Odontoma (HP:0011068): The presence of an odontoma. Evidence: TAS. Frequency: Very frequent (HP:0040281). (ORPHA:2724)
- Myocarditis (HP:0012819): Inflammation of the myocardium. Evidence: TAS. Frequency: Occasional (HP:0040283). (ORPHA:2724)
- Abnormal cardiovascular system morphology (HP:0030680): Any structural anomaly of the heart and blood vessels. Evidence: TAS. Frequency: Occasional (HP:0040283). (ORPHA:2724)
These phenotypes are associated with the disease Odontomatosis-aortae esophagus stenosis syndrome (ORPHA:2724).